- Torticollis (HP:0000473): Involuntary contractions of the neck musculature resulting in an abnormal posture of or abnormal movements of the head. Evidence: PCS. Frequency: 1/2. (PMID:25039795)
- Reduced social responsiveness (HP:0012760): A reduced ability to participate in the back-and-forth flow of social interaction appropriate to culture and developmental level, which is normally characterized by an influence of the behavior of one person on the behavior of another person. This results in difficulty interacting with others through emotional, physical, or verbal communication. Evidence: PCS. Frequency: 1/2. (PMID:25039795)
- Mild intellectual disability (HP:0001256): Mild intellectual disability (ID) is defined as a type of ID characterized by mildly sub-average adaptive functioning and intellectual functioning, with an intelligence quotient (IQ) the range of 50-69. Evidence: PCS. Frequency: 1/2. (PMID:25039795)
- Atonic seizure (HP:0010819): Atonic seizure is a type of motor seizure characterized by a sudden loss or diminution of muscle tone without apparent preceding myoclonic or tonic event lasting about 1 to 2 seconds, involving head, trunk, jaw, or limb musculature. Evidence: PCS. Frequency: 2/2. (PMID:25039795)
- Global developmental delay (HP:0001263): A delay in the achievement of motor or mental milestones in the domains of development of a child, including motor skills, speech and language, cognitive skills, and social and emotional skills. This term should only be used to describe children younger than five years of age. Evidence: PCS. Frequency: 7/8. (PMID:25039795;PMID:17847003)
- Infantile onset (HP:0003593): Onset of signs or symptoms of disease between 28 days to one year of life. Evidence: PCS. Frequency: 2/2. (PMID:25039795)
- Postural tremor (HP:0002174): A type of tremors that is triggered by holding a limb in a fixed position. Evidence: PCS. Frequency: 1/2. (PMID:25039795)
- Kinetic tremor (HP:0030186): Tremor that occurs during any voluntary movement. It may include visually or non-visually guided movements. Tremor during target directed movement is called intention tremor. Evidence: PCS. Frequency: 1/2. (PMID:25039795)
- Autosomal recessive inheritance (HP:0000007): A mode of inheritance that is observed for traits related to a gene encoded on one of the autosomes (i.e., the human chromosomes 1-22) in which a trait manifests in individuals with two pathogenic alleles, either homozygotes (two copies of the same mutant allele) or compound heterozygotes (whereby each copy of a gene has a distinct mutant allele). Evidence: PCS. (PMID:17847003)
- Intellectual disability (HP:0001249): The term intellectual disability or intellectual developmental disorder is used to describe significantly sub-average intellectual and adaptive functioning based on clinical assessment and as measured by individually administered, appropriately normed, standardized and validated tests of intellectual functioning and adaptive behavior, with onset during the developmental period from infancy through adolescence. Evidence: PCS. Frequency: 7/8. (PMID:25039795;PMID:17847003)
- Involuntary movements (HP:0004305): Involuntary contractions of muscle leading to involuntary movements of extremities, neck, trunk, or face. Evidence: PCS. Frequency: 1/2. (PMID:25039795)
- Myoclonus (HP:0001336): Very brief, involuntary random muscular contractions occurring at rest, in response to sensory stimuli, or accompanying voluntary movements. Evidence: PCS. Frequency: 1/2. (PMID:25039795)
These phenotypes are associated with the disease intellectual disability, autosomal recessive 6 (OMIM:611092).